- Diffuse telangiectasia (HP:0007489): Telangiectases (small dilated blood vessels) with a diffuse localization. Evidence: TAS. Frequency: Obligate (HP:0040280). (ORPHA:280779)
- Petechiae (HP:0000967): Petechiae are pinpoint-sized reddish/purple spots, resembling a rash, that appear just under the skin or a mucous membrane when capillaries have ruptured and some superficial bleeding into the skin has happened. This term refers to an abnormally increased susceptibility to developing petechiae. Evidence: TAS. Frequency: Very frequent (HP:0040281). (ORPHA:280779)
- Bruising susceptibility (HP:0000978): An ecchymosis (bruise) refers to the skin discoloration caused by the escape of blood into the tissues from ruptured blood vessels. This term refers to an abnormally increased susceptibility to bruising. The corresponding phenotypic abnormality is generally elicited on medical history as a report of frequent ecchymoses or bruising without adequate trauma. Evidence: TAS. Frequency: Very frequent (HP:0040281). (ORPHA:280779)
- Skin rash (HP:0000988): A red eruption of the skin. Evidence: TAS. Frequency: Very frequent (HP:0040281). (ORPHA:280779)
- Prominent superficial blood vessels (HP:0007394). Evidence: TAS. Frequency: Very frequent (HP:0040281). (ORPHA:280779)
- Erythema (HP:0010783): Redness of the skin, caused by hyperemia of the capillaries in the lower layers of the skin. Evidence: TAS. Frequency: Very frequent (HP:0040281). (ORPHA:280779)
- Vascular skin abnormality (HP:0011276). Evidence: TAS. Frequency: Very frequent (HP:0040281). (ORPHA:280779)
- Macule (HP:0012733): A flat, distinct, discolored area of skin less than 1 cm wide that does not involve any change in the thickness or texture of the skin. Evidence: TAS. Frequency: Very frequent (HP:0040281). (ORPHA:280779)
- Abnormality of metabolism/homeostasis (HP:0001939). Evidence: TAS. Frequency: Frequent (HP:0040282). (ORPHA:280779)
- Pruritus (HP:0000989): Pruritus is an itch or a sensation that makes a person want to scratch. This term refers to an abnormally increased disposition to experience pruritus. Evidence: TAS. Frequency: Occasional (HP:0040283). (ORPHA:280779)
These phenotypes are associated with the disease Cutaneous collagenous vasculopathy (ORPHA:280779).